- Wide mouth (HP:0000154): Distance between the oral commissures more than 2 SD above the mean. Alternatively, an apparently increased width of the oral aperture (subjective). Evidence: TAS. Frequency: Occasional (HP:0040283). (ORPHA:293948)
- Macrocephaly (HP:0000256): Occipitofrontal (head) circumference greater than 97th centile compared to appropriate, age matched, sex-matched normal standards. Alternatively, a apparently increased size of the cranium. Evidence: TAS. Frequency: Frequent (HP:0040282). (ORPHA:293948)
- Full cheeks (HP:0000293): Increased prominence or roundness of soft tissues between zygomata and mandible. Evidence: TAS. Frequency: Frequent (HP:0040282). (ORPHA:293948)
- Micrognathia (HP:0000347): Developmental hypoplasia of the mandible. Evidence: TAS. Frequency: Occasional (HP:0040283). (ORPHA:293948)
- Broad nasal tip (HP:0000455): Increase in width of the nasal tip. Evidence: TAS. Frequency: Frequent (HP:0040282). (ORPHA:293948)
- Astigmatism (HP:0000483): A type of refraction error associated with abnormal curvatures on the anterior and/or posterior surface of the cornea. Evidence: TAS. Frequency: Very frequent (HP:0040281). (ORPHA:293948)
- Deeply set eye (HP:0000490): An eye that is more deeply recessed into the plane of the face than is typical. Evidence: TAS. Frequency: Frequent (HP:0040282). (ORPHA:293948)
- Abnormality of vision (HP:0000504): Abnormality of eyesight (visual perception). Evidence: TAS. Frequency: Very frequent (HP:0040281). (ORPHA:293948)
- Myopia (HP:0000545): An abnormality of refraction characterized by the ability to see objects nearby clearly, while objects in the distance appear blurry. Evidence: TAS. Frequency: Very frequent (HP:0040281). (ORPHA:293948)
- Upslanted palpebral fissure (HP:0000582): The palpebral fissure inclination is more than two standard deviations above the mean for age (objective); or, the inclination of the palpebral fissure is greater than typical for age. Evidence: TAS. Frequency: Frequent (HP:0040282). (ORPHA:293948)
- Atypical behavior (HP:0000708): Atypical behavior is an abnormality in a person's actions that can be controlled or modulated by the will of the individual. While abnormal behaviors can be difficult to control, they are distinct from other abnormal actions that cannot be affected by the individual's will. Evidence: TAS. Frequency: Frequent (HP:0040282). (ORPHA:293948)
- Aggressive behavior (HP:0000718): Behavior or an act aimed at harming a person, animal, or physical property (e.g., acts of physical violence; shouting, swearing, and using harsh language; slashing someone's tires). Evidence: TAS. Frequency: Occasional (HP:0040283). (ORPHA:293948)
- Autistic behavior (HP:0000729): Persistent deficits in social interaction and communication and interaction as well as a markedly restricted repertoire of activity and interest as well as repetitive patterns of behavior. Evidence: TAS. Frequency: Frequent (HP:0040282). (ORPHA:293948)
- Self-mutilation (HP:0000742): Deliberate harm to one's body resulting in tissue damage, without a conscious intent to die. Evidence: TAS. Frequency: Occasional (HP:0040283). (ORPHA:293948)
- Delayed speech and language development (HP:0000750): A degree of language development that is significantly below the norm for a child of a specified age. Evidence: TAS. Frequency: Frequent (HP:0040282). (ORPHA:293948)
- Intellectual disability (HP:0001249): The term intellectual disability or intellectual developmental disorder is used to describe significantly sub-average intellectual and adaptive functioning based on clinical assessment and as measured by individually administered, appropriately normed, standardized and validated tests of intellectual functioning and adaptive behavior, with onset during the developmental period from infancy through adolescence. Evidence: TAS. Frequency: Very frequent (HP:0040281). (ORPHA:293948)
- Mild intellectual disability (HP:0001256): Mild intellectual disability (ID) is defined as a type of ID characterized by mildly sub-average adaptive functioning and intellectual functioning, with an intelligence quotient (IQ) the range of 50-69. Evidence: TAS. Frequency: Very frequent (HP:0040281). (ORPHA:293948)
- Global developmental delay (HP:0001263): A delay in the achievement of motor or mental milestones in the domains of development of a child, including motor skills, speech and language, cognitive skills, and social and emotional skills. This term should only be used to describe children younger than five years of age. Evidence: TAS. Frequency: Very frequent (HP:0040281). (ORPHA:293948)
- Joint hypermobility (HP:0001382): The capability that a joint (or a group of joints) has to move, passively and/or actively, beyond normal limits along physiological axes. Evidence: TAS. Frequency: Occasional (HP:0040283). (ORPHA:293948)
- Obesity (HP:0001513): Accumulation of substantial excess body fat. Evidence: TAS. Frequency: Very frequent (HP:0040281). (ORPHA:293948)
- Short nose (HP:0003196): Distance from nasion to subnasale more than two standard deviations below the mean, or alternatively, an apparently decreased length from the nasal root to the nasal tip. Evidence: TAS. Frequency: Frequent (HP:0040282). (ORPHA:293948)
- Self-injurious behavior (HP:0100716): Self-aggression. Evidence: TAS. Frequency: Occasional (HP:0040283). (ORPHA:293948)
- Abnormal eating behavior (HP:0100738): Abnormal eating habits involve excessive or insufficient consumption of food, or any other abnormal pattern of food consumption. Evidence: TAS. Frequency: Very frequent (HP:0040281). (ORPHA:293948)
- Excessive shyness (HP:0100962): Atypically high degree of awkwardness or apprehension experienced when approaching or being approached by others. Evidence: TAS. Frequency: Very frequent (HP:0040281). (ORPHA:293948)
- Long ear (HP:0400004): Median longitudinal ear length greater than two SD above the mean determined by the maximal distance from the superior aspect to the inferior aspect of the external ear. Evidence: TAS. Frequency: Very frequent (HP:0040281). (ORPHA:293948)
These phenotypes are associated with the disease 1p21.3 microdeletion syndrome (ORPHA:293948).